Phenotypes associated with the disease combined oxidative phosphorylation deficiency 38 (OMIM:618378):
- Delayed speech and language development (HP:0000750): A degree of language development that is significantly below the norm for a child of a specified age. Evidence: PCS. Frequency: 1/1. (PMID:30358850)
- Delayed ability to walk (HP:0031936): A failure to achieve the ability to walk at an appropriate developmental stage. Most children learn to walk in a series of stages, and learn to walk short distances independently between 12 and 15 months. Evidence: PCS. Frequency: 1/1. (PMID:30358850)
- Decreased activity of mitochondrial complex III (HP:0011924): A reduction in the activity of the mitochondrial respiratory chain complex III, which is part of the electron transport chain in mitochondria. Evidence: PCS. Frequency: 1/1. (PMID:30358850)
- Decreased activity of mitochondrial ATP synthase complex (HP:0011925): A reduction in the activity of the mitochondrial proton-transporting ATP synthase complex, which makes ATP via oxidative phosphorylation, and is sometimes described as Complex V of the electron transport chain. Evidence: PCS. Frequency: 1/1. (PMID:30358850)
- Global developmental delay (HP:0001263): A delay in the achievement of motor or mental milestones in the domains of development of a child, including motor skills, speech and language, cognitive skills, and social and emotional skills. This term should only be used to describe children younger than five years of age. Evidence: PCS. Frequency: 1/1. (PMID:30358850)
- Increased circulating lactate concentration (HP:0002151): Abnormally increased level of blood lactate (2-hydroxypropanoic acid). Lactate is produced from pyruvate by lactate dehydrogenase during normal metabolism. The terms lactate and lactic acid are often used interchangeably but lactate (the component measured in blood) is strictly a weak base whereas lactic acid is the corresponding acid. Lactic acidosis is often used clinically to describe elevated lactate but should be reserved for cases where there is a corresponding acidosis (pH below 7.35). Evidence: PCS. Frequency: 1/1. (PMID:30358850)
- Generalized hypotonia (HP:0001290): Generalized muscular hypotonia (abnormally low muscle tone). Evidence: PCS. Frequency: 1/1. (PMID:30358850)
- Midface retrusion (HP:0011800): Posterior positions and/or vertical shortening of the infraorbital and perialar regions, or increased concavity of the face and/or reduced nasolabial angle. Evidence: PCS. Frequency: 1/1. (PMID:30358850)
- Respiratory insufficiency (HP:0002093). Evidence: PCS. Frequency: 1/1. (PMID:30358850)
- Decreased activity of mitochondrial complex I (HP:0011923): A reduction in the activity of the mitochondrial respiratory chain complex I, which is part of the electron transport chain in mitochondria. Evidence: PCS. Frequency: 1/1. (PMID:30358850)
- Depressed nasal bridge (HP:0005280): Posterior positioning of the nasal root in relation to the overall facial profile for age. Evidence: PCS. Frequency: 1/1. (PMID:30358850)
- Failure to thrive (HP:0001508): Failure to thrive (FTT) refers to a child whose physical growth is substantially below the norm. Evidence: PCS. Frequency: 1/1. (PMID:30358850)
- Hypertrophic cardiomyopathy (HP:0001639): Hypertrophic cardiomyopathy (HCM) is defined by the presence of increased ventricular wall thickness or mass in the absence of loading conditions (hypertension, valve disease) sufficient to cause the observed abnormality. Evidence: PCS. Frequency: 1/1. Onset: Antenatal onset (HP:0030674). (PMID:30358850)
- Wolff-Parkinson-White syndrome (HP:0001716): A disorder of the cardiac conduction system of the heart characterized by ventricular preexcitation due to the presence of an abnormal accessory atrioventricular electrical conduction pathway. Evidence: PCS. Frequency: 1/1. (PMID:30358850)
- Hypertelorism (HP:0000316): Interpupillary distance more than 2 SD above the mean (alternatively, the appearance of an increased interpupillary distance or widely spaced eyes). Evidence: PCS. Frequency: 1/1. (PMID:30358850)
- Abnormal mitochondrial morphology (HP:0008322): Any structural anomaly of the mitochondria. Evidence: PCS. Frequency: 1/1. (PMID:30358850)
- Autosomal recessive inheritance (HP:0000007): A mode of inheritance that is observed for traits related to a gene encoded on one of the autosomes (i.e., the human chromosomes 1-22) in which a trait manifests in individuals with two pathogenic alleles, either homozygotes (two copies of the same mutant allele) or compound heterozygotes (whereby each copy of a gene has a distinct mutant allele). Evidence: PCS. (PMID:30358850)
- Decreased activity of mitochondrial complex IV (HP:0008347): A reduction in the activity of the mitochondrial respiratory chain complex IV, which is part of the electron transport chain in mitochondria. Evidence: PCS. Frequency: 1/1. (PMID:30358850)
- Low-set ears (HP:0000369): Upper insertion of the ear to the scalp below an imaginary horizontal line drawn between the inner canthi of the eye and extending posteriorly to the ear. Evidence: PCS. Frequency: 1/1. (PMID:30358850)
- Posteriorly rotated ears (HP:0000358): A type of abnormal location of the ears in which the position of the ears is characterized by posterior rotation (the superior part of the ears is rotated towards the back of the head, and the inferior part of the ears towards the front). Evidence: PCS. Frequency: 1/1. (PMID:30358850)
- Lactic acidosis (HP:0003128): An abnormal buildup of lactic acid in the body, leading to acidification of the blood and other bodily fluids. Evidence: PCS. Frequency: 1/1. (PMID:30358850)
- Hyperalaninemia (HP:0003348): An increased concentration of alanine in the blood. Evidence: PCS. Frequency: 1/1. (PMID:30358850)